- Abnormality of the dentition (HP:0000164): Any abnormality of the teeth. Evidence: TAS. Frequency: Very frequent (HP:0040281). (ORPHA:2380)
- Joint dislocation (HP:0001373): Displacement or malalignment of joints. Evidence: TAS. Frequency: Very frequent (HP:0040281). (ORPHA:2380)
- Delayed skeletal maturation (HP:0002750): A decreased rate of skeletal maturation. Delayed skeletal maturation can be diagnosed on the basis of an estimation of the bone age from radiographs of specific bones in the human body. Evidence: TAS. Frequency: Very frequent (HP:0040281). (ORPHA:2380)
- Arthralgia (HP:0002829): Joint pain. Evidence: TAS. Frequency: Very frequent (HP:0040281). (ORPHA:2380)
- Skeletal muscle atrophy (HP:0003202): The presence of skeletal muscular atrophy (which is also known as amyotrophy). Evidence: TAS. Frequency: Very frequent (HP:0040281). (ORPHA:2380)
- Short stature (HP:0004322): A height below that which is expected according to age and gender norms. Although there is no universally accepted definition of short stature, many refer to "short stature" as height more than 2 standard deviations below the mean for age and gender (or below the 3rd percentile for age and gender dependent norms). Evidence: TAS. Frequency: Very frequent (HP:0040281). (ORPHA:2380)
- Avascular necrosis (HP:0010885): A disease where there is cellular death (necrosis) of bone components due to interruption of the blood supply. Evidence: TAS. Frequency: Very frequent (HP:0040281). (ORPHA:2380)
- Cartilage destruction (HP:0100773). Evidence: TAS. Frequency: Very frequent (HP:0040281). (ORPHA:2380)
These phenotypes are associated with the disease Legg-Calvé-Perthes disease (ORPHA:2380).